- Strabismus (HP:0000486): A misalignment of the eyes so that the visual axes deviate from bifoveal fixation. The classification of strabismus may be based on a number of features including the relative position of the eyes, whether the deviation is latent or manifest, intermittent or constant, concomitant or otherwise and according to the age of onset and the relevance of any associated refractive error. Evidence: PCS. Frequency: 1/5. (PMID:30941876)
- Cerebellar atrophy (HP:0001272): Cerebellar atrophy is defined as a cerebellum with initially normal structures, in a posterior fossa with normal size, which displays enlarged fissures (interfolial spaces) in comparison to the foliae secondary to loss of tissue. Cerebellar atrophy implies irreversible loss of tissue and result from an ongoing progressive disease until a final stage is reached or a single injury, e.g. an intoxication or infectious event. Evidence: PCS. Frequency: 1/3. (PMID:30941876)
- Seizure (HP:0001250): A seizure is an intermittent abnormality of nervous system physiology characterized by a transient occurrence of signs and/or symptoms due to abnormal excessive or synchronous neuronal activity in the brain. Evidence: PCS. Frequency: 3/7. (PMID:24123876;PMID:30941876)
- Hypotonia (HP:0001252): Hypotonia is an abnormally low muscle tone (the amount of tension or resistance to movement in a muscle). Even when relaxed, muscles have a continuous and passive partial contraction which provides some resistance to passive stretching. Hypotonia thus manifests as diminished resistance to passive stretching. Hypotonia is not the same as muscle weakness, although the two conditions can co-exist. Evidence: PCS. Frequency: 4/7. (PMID:24123876;PMID:30941876)
- Infantile onset (HP:0003593): Onset of signs or symptoms of disease between 28 days to one year of life. Evidence: PCS. Frequency: 5/5. (PMID:30941876)
- Coarse facial features (HP:0000280): Absence of fine and sharp appearance of brows, nose, lips, mouth, and chin, usually because of rounded and heavy features or thickened skin with or without thickening of subcutaneous and bony tissues. Evidence: PCS. Frequency: 2/2. (PMID:24123876)
- Sparse hair (HP:0008070): Reduced density of hairs. Evidence: PCS. Frequency: 2/5. (PMID:30941876)
- Severe intellectual disability (HP:0010864): Severe intellectual disability (ID) is defined as a type of ID characterized by severely sub-average adaptive functioning and intellectual functioning, with an intelligence quotient (IQ) the range of 20-34. Evidence: PCS. Frequency: 2/2. (PMID:24123876)
- Aggressive behavior (HP:0000718): Behavior or an act aimed at harming a person, animal, or physical property (e.g., acts of physical violence; shouting, swearing, and using harsh language; slashing someone's tires). Evidence: PCS. Frequency: 2/5. (PMID:30941876)
- Hypertelorism (HP:0000316): Interpupillary distance more than 2 SD above the mean (alternatively, the appearance of an increased interpupillary distance or widely spaced eyes). Evidence: PCS. Frequency: 2/5. (PMID:30941876)
- Long fingers (HP:0100807): The middle finger is more than 2 SD above the mean for newborns 27 to 41 weeks EGA or above the 97th centile for children from birth to 16 years of age AND the five digits retain their normal length proportions relative to each other (i.e., it is not the case that the middle finger is the only lengthened digit), or, Fingers that appear disproportionately long compared to the palm of the hand. Evidence: PCS. Frequency: 3/5. (PMID:30941876)
- Motor stereotypy (HP:0000733): Use of the same abnormal action in response to certain triggers or at random. They may be used as a way to regulate one's internal state but must otherwise have no apparent functional purpose. Evidence: PCS. Frequency: 2/5. (PMID:30941876)
- Exotropia (HP:0000577): A form of strabismus with one or both eyes deviated outward. Evidence: PCS. Frequency: 1/5. (PMID:30941876)
- Broad-based gait (HP:0002136): An abnormal gait pattern in which persons stand and walk with their feet spaced widely apart. This is often a component of cerebellar ataxia. Evidence: PCS. Frequency: 1/5. (PMID:30941876)
- Downslanted palpebral fissures (HP:0000494): The palpebral fissure inclination is more than two standard deviations below the mean. Evidence: PCS. Frequency: 2/5. (PMID:30941876)
- Delayed speech and language development (HP:0000750): A degree of language development that is significantly below the norm for a child of a specified age. Evidence: PCS. Frequency: 3/4. (PMID:30941876)
- Long face (HP:0000276): Facial height (length) is more than 2 standard deviations above the mean (objective); or, an apparent increase in the height (length) of the face (subjective). Evidence: PCS. Frequency: 1/5. (PMID:30941876)
- Global developmental delay (HP:0001263): A delay in the achievement of motor or mental milestones in the domains of development of a child, including motor skills, speech and language, cognitive skills, and social and emotional skills. This term should only be used to describe children younger than five years of age. Evidence: PCS. Frequency: 5/5. (PMID:30941876)
- Delayed gross motor development (HP:0002194): A type of motor delay characterized by a delay in acquiring the ability to control the large muscles of the body for walking, running, sitting, and crawling. Evidence: PCS. Frequency: 4/5. (PMID:30941876)
- Tapered finger (HP:0001182): The gradual reduction in girth of the finger from proximal to distal. Evidence: IEA. (OMIM:301029)
- Wide nasal base (HP:0012810): Increased distance between the attachments of the alae nasi to the face. Evidence: PCS. Frequency: 1/5. (PMID:30941876)
- Impulsivity (HP:0100710): Acting on the spur of the moment or on a momentary basis without consideration of outcomes; having difficulty establishing or following plans; experiencing a sense of urgency and engaging in behavior that is uninhibited, cannot be inhibited, and is uncontrolled. The possibility of repression is inconceivable. Evidence: PCS. Frequency: 2/5. (PMID:30941876)
- X-linked recessive inheritance (HP:0001419): A mode of inheritance that is observed for recessive traits related to a gene encoded on the X chromosome. In the context of medical genetics, X-linked recessive disorders manifest in males (who have one copy of the X chromosome and are thus hemizygotes), but generally not in female heterozygotes who have one mutant and one normal allele. Evidence: PCS. (PMID:24123876)
- Autistic behavior (HP:0000729): Persistent deficits in social interaction and communication and interaction as well as a markedly restricted repertoire of activity and interest as well as repetitive patterns of behavior. Evidence: PCS. Frequency: 5/5. (PMID:30941876)
- Pectus excavatum (HP:0000767): A defect of the chest wall characterized by a depression of the sternum, giving the chest ("pectus") a caved-in ("excavatum") appearance. Evidence: PCS. Frequency: 1/5. (PMID:30941876)
- High forehead (HP:0000348): An abnormally increased height of the forehead. Evidence: PCS. Frequency: 4/5. (PMID:30941876)
- Drooling (HP:0002307): Habitual flow of saliva out of the mouth. Evidence: PCS. Frequency: 2/5. (PMID:30941876)
- Attention deficit hyperactivity disorder (HP:0007018): Attention deficit hyperactivity disorder (ADHD) manifests at age 2-3 years or by first grade at the latest. The main symptoms are distractibility, impulsivity, hyperactivity, and often trouble organizing tasks and projects, difficulty going to sleep, and social problems from being aggressive, loud, or impatient. Evidence: PCS. Frequency: 2/5. (PMID:30941876)
These phenotypes are associated with the disease Shukla-Vernon syndrome (OMIM:301029).